- Juvenile onset (HP:0003621): Onset of signs or symptoms of disease between the age of 5 and 15 years. Evidence: PCS. Frequency: 1/1. (PMID:29403012)
- Increased circulating aldosterone concentration (HP:0000859): Overproduction of the mineralocorticoid aldosterone by the adrenal cortex. Evidence: PCS. (PMID:29403011)
- Typified by incomplete penetrance (HP:0003829): Description of conditions in which not all individuals with a given genotype exhibit the disease. Penetrance is the proportion that develop disease given a lifespan of 80 years. Evidence: PCS. (PMID:29403011)
- Hypertension (HP:0000822): The presence of chronic increased pressure in the systemic arterial system. Evidence: PCS. Frequency: 1/1. (PMID:29403012)
- Hypokalemia (HP:0002900): The concentration of potassium(1+) in the blood circulation is below the lower limit of normal. Evidence: PCS. Frequency: 1/1. (PMID:29403012)
- Autosomal dominant inheritance (HP:0000006): A mode of inheritance that is observed for traits related to a gene encoded on one of the autosomes (i.e., the human chromosomes 1-22) in which a trait manifests in heterozygotes. In the context of medical genetics, an autosomal dominant disorder is caused when a single copy of the mutant allele is present. Males and females are affected equally, and can both transmit the disorder with a risk of 50% for each child of inheriting the mutant allele. Evidence: PCS. (PMID:29403011)
These phenotypes are associated with the disease familial hyperaldosteronism type II (OMIM:605635).